- Congenital onset (HP:0003577, a Human Phenotype Ontology term): A phenotypic abnormality that is present at birth. Evidence: PCS. Frequency: 7/7. (PMID:11398101)
- Abnormal vestibular function (HP:0001751, a Human Phenotype Ontology term): An abnormality of the functioning of the vestibular apparatus. Evidence: PCS. Frequency: 7/8. (PMID:18719945)
- Impaired tandem gait (HP:0031629, a Human Phenotype Ontology term): Reduced ability to walk in a straight line while placing the feet heel to toe. Evidence: PCS. Frequency: 7/8. (PMID:18719945)
- Autosomal recessive inheritance (HP:0000007, a Human Phenotype Ontology term): A mode of inheritance that is observed for traits related to a gene encoded on one of the autosomes (i.e., the human chromosomes 1-22) in which a trait manifests in individuals with two pathogenic alleles, either homozygotes (two copies of the same mutant allele) or compound heterozygotes (whereby each copy of a gene has a distinct mutant allele). Evidence: PCS. (PMID:11398101)
- Motor delay (HP:0001270, a Human Phenotype Ontology term): A type of Developmental delay characterized by a delay in acquiring motor skills. Evidence: PCS. Frequency: 1/8. (PMID:18719945)
- Rod-cone dystrophy (HP:0000510, a Human Phenotype Ontology term): An inherited retinal disease subtype in which the rod photoreceptors appear to be more severely affected than the cone photoreceptors. Typical presentation is with nyctalopia (due to rod dysfunction) followed by loss of mid-peripheral field of vision, which gradually extends and leaves many patients with a small central island of vision due to the preservation of macular cones. Evidence: PCS. Frequency: 14/15. (PMID:11398101;PMID:18719945)
- Congenital sensorineural hearing impairment (HP:0008527, a Human Phenotype Ontology term): A type of hearing impairment caused by an abnormal functionality of the cochlear nerve with congenital onset. Evidence: PCS. Frequency: 15/15. (PMID:11398101;PMID:18719945)
These phenotypes are associated with the disease Usher syndrome type 1F (OMIM:602083, an entry in Online Mendelian Inheritance in Man).